Phenotypes associated with the disease autosomal recessive nonsyndromic hearing loss 84A (OMIM:613391):
- Hearing impairment (HP:0000365): A decreased magnitude of the sensory perception of sound. Evidence: IEA. (OMIM:613391)
- Abnormal vestibular function (HP:0001751): An abnormality of the functioning of the vestibular apparatus. Evidence: IEA. (OMIM:613391)
- Infantile onset (HP:0003593): Onset of signs or symptoms of disease between 28 days to one year of life. Evidence: IEA. (OMIM:613391)
- Autosomal recessive inheritance (HP:0000007): A mode of inheritance that is observed for traits related to a gene encoded on one of the autosomes (i.e., the human chromosomes 1-22) in which a trait manifests in individuals with two pathogenic alleles, either homozygotes (two copies of the same mutant allele) or compound heterozygotes (whereby each copy of a gene has a distinct mutant allele). Evidence: IEA. (OMIM:613391)
- Motor delay (HP:0001270): A type of Developmental delay characterized by a delay in acquiring motor skills. Evidence: IEA. (OMIM:613391)